- Type I transferrin isoform profile (HP:0003642): Abnormal transferrin isoform profile consistent with a type I congenital disorder of glycosylation. In the traditional nomenclature for congenital disorders of glycosylation, absence of entire glycans was designated type I, and loss of one or more monosaccharides as type II. Evidence: PCS. Frequency: 1/1. (PMID:19576565)
- Juvenile onset (HP:0003621): Onset of signs or symptoms of disease between the age of 5 and 15 years. Evidence: PCS. Frequency: 1/1. (PMID:19576565)
- Elevated circulating creatine kinase activity (HP:0003236): The activity of creatine kinase in the blood circulation is above the upper limit of normal. Evidence: PCS. Frequency: 2/2. (PMID:19576565;PMID:28803818)
- Myopathy (HP:0003198): A disorder of muscle unrelated to impairment of innervation or neuromuscular junction. Evidence: PCS. Frequency: 1/1. (PMID:28803818)
- Adult onset (HP:0003581): Onset of disease manifestations in adulthood, defined here as at the age of 16 years or later. Evidence: PCS. Frequency: 1/1. (PMID:28803818)
- Gowers sign (HP:0003391): A phenomenon whereby patients are not able to stand up without the use of the hands owing to weakness of the proximal muscles of the lower limbs. Evidence: PCS. Frequency: 1/1. (PMID:28803818)
- Rimmed vacuoles (HP:0003805): Presence of abnormal vacuoles (membrane-bound organelles) in the sarcolemma. On histological staining with hematoxylin and eosin, rimmed vacuoles are popcorn-like clear vacuoles with a densely blue rim. The vacuoles are often associated with cytoplasmic and occasionally intranuclear eosinophilic inclusions. Evidence: PCS. Frequency: 1/1. (PMID:19576565)
- Autosomal recessive inheritance (HP:0000007): A mode of inheritance that is observed for traits related to a gene encoded on one of the autosomes (i.e., the human chromosomes 1-22) in which a trait manifests in individuals with two pathogenic alleles, either homozygotes (two copies of the same mutant allele) or compound heterozygotes (whereby each copy of a gene has a distinct mutant allele). Evidence: PCS. Frequency: 1/1. (PMID:19576565)
- Waddling gait (HP:0002515): Weakness of the hip girdle and upper thigh muscles, for instance in myopathies, leads to an instability of the pelvis on standing and walking. If the muscles extending the hip joint are affected, the posture in that joint becomes flexed and lumbar lordosis increases. The patients usually have difficulties standing up from a sitting position. Due to weakness in the gluteus medius muscle, the hip on the side of the swinging leg drops with each step (referred to as Trendelenburg sign). The gait appears waddling. The patients frequently attempt to counteract the dropping of the hip on the swinging side by bending the trunk towards the side which is in the stance phase (in the German language literature this is referred to as Duchenne sign). Similar gait patterns can be caused by orthopedic conditions when the origin and the insertion site of the gluteus medius muscle are closer to each other than normal, for instance due to a posttraumatic elevation of the trochanter or pseudarthrosis of the femoral neck. Evidence: PCS. Frequency: 1/1. (PMID:19576565)
- Unsteady gait (HP:0002317). Evidence: PCS. Frequency: 1/1. (PMID:28803818)
- Limb-girdle muscular dystrophy (HP:0006785): Muscular dystrophy affecting the muscles of the limb girdle (the hips and shoulders). Evidence: PCS. Frequency: 1/1. (PMID:28803818)
- Proximal muscle weakness (HP:0003701): A lack of strength of the proximal muscles. Evidence: PCS. Frequency: 1/1. (PMID:28803818)
- Muscle weakness (HP:0001324): Reduced strength of muscles. Evidence: PCS. Frequency: 1/1. (PMID:19576565)
- Elevated circulating hepatic transaminase concentration (HP:0002910): Elevations of the levels of SGOT and SGPT in the serum. SGOT (serum glutamic oxaloacetic transaminase) and SGPT (serum glutamic pyruvic transaminase) are transaminases primarily found in the liver and heart and are released into the bloodstream as the result of liver or heart damage. SGOT and SGPT are used clinically mainly as markers of liver damage. Evidence: PCS. Frequency: 1/1. (PMID:19576565)
- Increased variability in muscle fiber diameter (HP:0003557): An abnormally high degree of muscle fiber size variation. This phenotypic feature can be observed upon muscle biopsy. Evidence: PCS. Frequency: 1/1. (PMID:19576565)
- Dilated cardiomyopathy (HP:0001644): Dilated cardiomyopathy (DCM) is defined by the presence of left ventricular dilatation and left ventricular systolic dysfunction in the absence of abnormal loading conditions (hypertension, valve disease) or coronary artery disease sufficient to cause global systolic impairment. Right ventricular dilation and dysfunction may be present but are not necessary for the diagnosis. Evidence: PCS. Frequency: 1/1. (PMID:19576565)
These phenotypes are associated with the disease DPM3-congenital disorder of glycosylation (OMIM:612937).